- Hemihypertrophy (HP:0001528): Overgrowth of only one side of the body. Evidence: TAS. Frequency: Very frequent (HP:0040281). (ORPHA:2128)
- Asymmetry of the thorax (HP:0001555): Lack of symmetry between the left and right halves of the thorax. Evidence: TAS. Frequency: Very frequent (HP:0040281). (ORPHA:2128)
- Scoliosis (HP:0002650): The presence of an abnormal lateral curvature of the spine. Evidence: TAS. Frequency: Very frequent (HP:0040281). (ORPHA:2128)
- Abnormality of the dentition (HP:0000164): Any abnormality of the teeth. Evidence: TAS. Frequency: Frequent (HP:0040282). (ORPHA:2128)
- Facial asymmetry (HP:0000324): An abnormal difference between the left and right sides of the face. Evidence: TAS. Frequency: Frequent (HP:0040282). (ORPHA:2128)
- Mild intellectual disability (HP:0001256): Mild intellectual disability (ID) is defined as a type of ID characterized by mildly sub-average adaptive functioning and intellectual functioning, with an intelligence quotient (IQ) the range of 50-69. Evidence: TAS. Frequency: Frequent (HP:0040282). (ORPHA:2128)
- Inguinal hernia (HP:0000023): Protrusion of the contents of the abdominal cavity through the inguinal canal. Evidence: TAS. Frequency: Occasional (HP:0040283). (ORPHA:2128)
- Cryptorchidism (HP:0000028): Testis in inguinal canal. That is, absence of one or both testes from the scrotum owing to failure of the testis or testes to descend through the inguinal canal to the scrotum. Evidence: TAS. Frequency: Occasional (HP:0040283). (ORPHA:2128)
- Myelomeningocele (HP:0002475): Protrusion of the meninges and portions of the spinal cord through a defect of the vertebral column. Evidence: TAS. Frequency: Occasional (HP:0040283). (ORPHA:2128)
- Nephroblastoma (HP:0002667): The presence of a nephroblastoma, which is a neoplasm of the kidney that primarily affects children. Evidence: TAS. Frequency: Occasional (HP:0040283). (ORPHA:2128)
- Impaired pain sensation (HP:0007328): Reduced ability to perceive painful stimuli. Evidence: TAS. Frequency: Occasional (HP:0040283). (ORPHA:2128)
- Abnormal cardiovascular system morphology (HP:0030680): Any structural anomaly of the heart and blood vessels. Evidence: TAS. Frequency: Occasional (HP:0040283). (ORPHA:2128)
These phenotypes are associated with the disease Isolated hemihyperplasia (ORPHA:2128).